- Progressive (HP:0003676): Applies to a disease manifestation that increases in scope or severity over the course of time, i.e., that worsens with age. Evidence: PCS. (PMID:22200994)
- Increased circulating lactate concentration (HP:0002151): Abnormally increased level of blood lactate (2-hydroxypropanoic acid). Lactate is produced from pyruvate by lactate dehydrogenase during normal metabolism. The terms lactate and lactic acid are often used interchangeably but lactate (the component measured in blood) is strictly a weak base whereas lactic acid is the corresponding acid. Lactic acidosis is often used clinically to describe elevated lactate but should be reserved for cases where there is a corresponding acidosis (pH below 7.35). Evidence: PCS. Frequency: 1/1. (PMID:22200994)
- Hypotonia (HP:0001252): Hypotonia is an abnormally low muscle tone (the amount of tension or resistance to movement in a muscle). Even when relaxed, muscles have a continuous and passive partial contraction which provides some resistance to passive stretching. Hypotonia thus manifests as diminished resistance to passive stretching. Hypotonia is not the same as muscle weakness, although the two conditions can co-exist. Evidence: PCS. Frequency: 1/1. (PMID:22200994)
- Infantile onset (HP:0003593): Onset of signs or symptoms of disease between 28 days to one year of life. Evidence: PCS. Frequency: 1/1. (PMID:22200994)
- Autosomal recessive inheritance (HP:0000007): A mode of inheritance that is observed for traits related to a gene encoded on one of the autosomes (i.e., the human chromosomes 1-22) in which a trait manifests in individuals with two pathogenic alleles, either homozygotes (two copies of the same mutant allele) or compound heterozygotes (whereby each copy of a gene has a distinct mutant allele). Evidence: PCS. (PMID:22200994)
- Decreased activity of mitochondrial complex I (HP:0011923): A reduction in the activity of the mitochondrial respiratory chain complex I, which is part of the electron transport chain in mitochondria. Evidence: PCS. Frequency: 2/2. (PMID:22200994)
These phenotypes are associated with the disease mitochondrial complex I deficiency, nuclear type 24 (OMIM:618245).